Phenotypes associated with the disease mitral valve prolapse, myxomatous 2 (OMIM:607829):
- Mitral regurgitation (HP:0001653): An abnormality of the mitral valve characterized by insufficiency or incompetence of the mitral valve resulting in retrograde leaking of blood through the mitral valve upon ventricular contraction. Evidence: IEA. (OMIM:607829)
- Autosomal dominant inheritance (HP:0000006): A mode of inheritance that is observed for traits related to a gene encoded on one of the autosomes (i.e., the human chromosomes 1-22) in which a trait manifests in heterozygotes. In the context of medical genetics, an autosomal dominant disorder is caused when a single copy of the mutant allele is present. Males and females are affected equally, and can both transmit the disorder with a risk of 50% for each child of inheriting the mutant allele. Evidence: IEA. (OMIM:607829)
- Mitral valve prolapse (HP:0001634): One or both of the leaflets (cusps) of the mitral valve bulges back into the left atrium upon contraction of the left ventricle. Evidence: IEA. (OMIM:607829)
- Typified by age-related disease onset (HP:0003831): Description of conditions in which age of onset is typically later in life and in which penetrance is dependent on the age of the subject. Evidence: IEA. (OMIM:607829)